- Stroke (HP:0001297): Sudden impairment of blood flow to a part of the brain due to occlusion or rupture of an artery to the brain. Evidence: PCS. (PMID:20042462)
- Adult onset (HP:0003581): Onset of disease manifestations in adulthood, defined here as at the age of 16 years or later. Evidence: PCS. (PMID:20042462)
- Non-Mendelian inheritance (HP:0001426): A mode of inheritance that depends on genetic determinants in more than one gene. Evidence: PCS. (PMID:20042462)
These phenotypes are associated with the disease Ischemic stroke, susceptibility to (OMIM:601367).